- Abnormal palate morphology (HP:0000174): Any abnormality of the palate, i.e., of roof of the mouth. Evidence: TAS. Frequency: Frequent (HP:0040282). (ORPHA:2533)
- Everted lower lip vermilion (HP:0000232): An abnormal configuration of the lower lip such that it is turned outward i.e., everted, with the Inner aspect of the lower lip vermilion (normally opposing the teeth) being visible in a frontal view. Evidence: TAS. Frequency: Very frequent (HP:0040281). (ORPHA:2533)
- Microcephaly (HP:0000252): Head circumference below 2 standard deviations below the mean for age and gender. Evidence: TAS. Frequency: Very frequent (HP:0040281). (ORPHA:2533)
- Epicanthus (HP:0000286): A fold of skin starting above the medial aspect of the upper eyelid and arching downward to cover, pass in front of and lateral to the medial canthus. Evidence: TAS. Frequency: Very frequent (HP:0040281). (ORPHA:2533)
- Facial asymmetry (HP:0000324): An abnormal difference between the left and right sides of the face. Evidence: TAS. Frequency: Very frequent (HP:0040281). (ORPHA:2533)
- Micrognathia (HP:0000347): Developmental hypoplasia of the mandible. Evidence: TAS. Frequency: Very frequent (HP:0040281). (ORPHA:2533)
- Low-set ears (HP:0000369): Upper insertion of the ear to the scalp below an imaginary horizontal line drawn between the inner canthi of the eye and extending posteriorly to the ear. Evidence: TAS. Frequency: Very frequent (HP:0040281). (ORPHA:2533)
- Cupped ear (HP:0000378): Laterally protruding ear that lacks antihelical folding (including absence of inferior and superior crura). Evidence: TAS. Frequency: Very frequent (HP:0040281). (ORPHA:2533)
- Preauricular skin tag (HP:0000384): A rudimentary tag of skin often containing ear tissue including a core of cartilage and located just anterior to the auricle (outer part of the ear). Evidence: TAS. Frequency: Frequent (HP:0040282). (ORPHA:2533)
- Sensorineural hearing impairment (HP:0000407): A type of hearing impairment in one or both ears related to an abnormal functionality of the cochlear nerve. Evidence: TAS. Frequency: Very frequent (HP:0040281). (ORPHA:2533)
- Protruding ear (HP:0000411): Angle formed by the plane of the ear and the mastoid bone greater than the 97th centile for age (objective); or, outer edge of the helix more than 2 cm from the mastoid at the point of maximum distance (objective). Evidence: TAS. Frequency: Very frequent (HP:0040281). (ORPHA:2533)
- Intellectual disability (HP:0001249): The term intellectual disability or intellectual developmental disorder is used to describe significantly sub-average intellectual and adaptive functioning based on clinical assessment and as measured by individually administered, appropriately normed, standardized and validated tests of intellectual functioning and adaptive behavior, with onset during the developmental period from infancy through adolescence. Evidence: TAS. Frequency: Very frequent (HP:0040281). (ORPHA:2533)
- Prominent glabella (HP:0002057): Forward protrusion of the glabella. Evidence: TAS. Frequency: Very frequent (HP:0040281). (ORPHA:2533)
- Abnormal speech pattern (HP:0002167): An abnormality in the sound (volume) or cadence (rate) of speech. Evidence: TAS. Frequency: Frequent (HP:0040282). (ORPHA:2533)
- Short stature (HP:0004322): A height below that which is expected according to age and gender norms. Although there is no universally accepted definition of short stature, many refer to "short stature" as height more than 2 standard deviations below the mean for age and gender (or below the 3rd percentile for age and gender dependent norms). Evidence: TAS. Frequency: Frequent (HP:0040282). (ORPHA:2533)
These phenotypes are associated with the disease Microcephaly-deafness-intellectual disability syndrome (ORPHA:2533).